- Growth delay (HP:0001510): A deficiency or slowing down of growth pre- and postnatally. Evidence: TAS. Frequency: Very frequent (HP:0040281). (ORPHA:2867)
- Abnormal facial shape (HP:0001999): An abnormal morphology (form) of the face or its components. Evidence: TAS. Frequency: Very frequent (HP:0040281). (ORPHA:2867)
- Short stature (HP:0004322): A height below that which is expected according to age and gender norms. Although there is no universally accepted definition of short stature, many refer to "short stature" as height more than 2 standard deviations below the mean for age and gender (or below the 3rd percentile for age and gender dependent norms). Evidence: TAS. Frequency: Very frequent (HP:0040281). (ORPHA:2867)
- Horseshoe kidney (HP:0000085): A connection of the right and left kidney by an isthmus of functioning renal parenchyma or fibrous tissue that crosses the midline. Evidence: TAS. Frequency: Frequent (HP:0040282). (ORPHA:2867)
- Macrocephaly (HP:0000256): Occipitofrontal (head) circumference greater than 97th centile compared to appropriate, age matched, sex-matched normal standards. Alternatively, a apparently increased size of the cranium. Evidence: TAS. Frequency: Frequent (HP:0040282). (ORPHA:2867)
- Microretrognathia (HP:0000308): A form of developmental hypoplasia of the mandible in which the mandible is mislocalised posteriorly. Evidence: TAS. Frequency: Frequent (HP:0040282). (ORPHA:2867)
- Triangular face (HP:0000325): Facial contour, as viewed from the front, triangular in shape, with breadth at the temples and tapering to a narrow chin. Evidence: TAS. Frequency: Frequent (HP:0040282). (ORPHA:2867)
- Narrow chest (HP:0000774): Reduced width of the chest from side to side, associated with a reduced distance from the sternal notch to the tip of the shoulder. Evidence: TAS. Frequency: Frequent (HP:0040282). (ORPHA:2867)
- Delayed epiphyseal ossification (HP:0002663). Evidence: TAS. Frequency: Frequent (HP:0040282). (ORPHA:2867)
- Calcification of cartilage (HP:0100593): The presence of calcium deposition in cartilage. Evidence: TAS. Frequency: Frequent (HP:0040282). (ORPHA:2867)
These phenotypes are associated with the disease Short stature, Brussels type (ORPHA:2867).